Phenotypes associated with the disease long QT syndrome 12 (OMIM:612955):
- Ventricular fibrillation (HP:0001663): Uncontrolled contractions of muscles fibers in the left ventricle not producing contraction of the left ventricle. Ventricular fibrillation usually begins with a ventricular premature contraction and a short run of rapid ventricular tachycardia degenerating into uncoordinating ventricular fibrillations. Evidence: TAS. (OMIM:612955)
- Early young adult onset (HP:0025708): Onset of disease at an age of greater than or equal to 16 to under 19 years. Evidence: PCS. Frequency: 1/1. (PMID:18591664)
- Prolonged QTc interval (HP:0005184): A longer than normal interval (corrected for heart rate) between the Q and T waves in the heart's cycle. Prolonged QTc can cause premature action potentials during late phase depolarizations thereby leading to ventricular arrhythmias and ventricular fibrillations. Evidence: PCS. Frequency: 1/1. (PMID:18591664)
- Syncope (HP:0001279): A transient loss of consciousness (i.e., characterized by a rapid onset, a short duration, and a spontaneous and complete recovery) due to cerebral hypoperfusion. Evidence: PCS. Frequency: 1/1. (PMID:18591664)
- Torsade de pointes (HP:0001664): A type of ventricular tachycardia characterized by polymorphioc QRS complexes that change in amplitue and cycle length, and thus have the appearance of oscillating around the baseline in the EKG. Evidence: PCS. (PMID:10220144)
- Autosomal dominant inheritance (HP:0000006): A mode of inheritance that is observed for traits related to a gene encoded on one of the autosomes (i.e., the human chromosomes 1-22) in which a trait manifests in heterozygotes. In the context of medical genetics, an autosomal dominant disorder is caused when a single copy of the mutant allele is present. Males and females are affected equally, and can both transmit the disorder with a risk of 50% for each child of inheriting the mutant allele. Evidence: PCS. (PMID:18591664)